- Protrusio acetabuli (HP:0003179): Intrapelvic bulging of the medial acetabular wall. Evidence: PCS. (PMID:629604)
- Hip contracture (HP:0003273): Lack of full passive range of motion (restrictions in flexion, extension, or other movements) of the hip joint resulting from structural changes of non-bony tissues, such as muscles, tendons, ligaments, joint capsules and/or skin. Evidence: PCS. (PMID:629604)
- Hip pain (HP:0030838): An unpleasant sensation characterized by physical discomfort (such as pricking, throbbing, or aching) localized to the hip. Evidence: PCS. Frequency: 20/20. (OMIM:177050;PMID:629604)
- Autosomal dominant inheritance (HP:0000006): A mode of inheritance that is observed for traits related to a gene encoded on one of the autosomes (i.e., the human chromosomes 1-22) in which a trait manifests in heterozygotes. In the context of medical genetics, an autosomal dominant disorder is caused when a single copy of the mutant allele is present. Males and females are affected equally, and can both transmit the disorder with a risk of 50% for each child of inheriting the mutant allele. Evidence: IEA. (OMIM:177050)
These phenotypes are associated with the disease Protrusio acetabuli (OMIM:177050).